- Follicular hyperplasia (HP:0002729): Lymphadenopathy (enlargement of lymph nodes) owing to hyperplasia of follicular (germinal) centers. Evidence: TAS. Frequency: Frequent (HP:0040282). (ORPHA:60026)
- Cough (HP:0012735): A sudden, audible expulsion of air from the lungs through a partially closed glottis, preceded by inhalation. Evidence: TAS. Frequency: Frequent (HP:0040282). (ORPHA:60026)
- Nodular pattern on pulmonary HRCT (HP:0025392): A nodular pattern is characterized on pulmonary high-resolution computed tomography by the presence of numerous rounded opacities that range from 2 mm to 1 cm in diameter, with micronodules defined as smaller than 3 mm in diameter. Evidence: TAS. Frequency: Frequent (HP:0040282). (ORPHA:60026)
- Plasmacytosis (HP:0030150): An abnormally increased number of plasma cells in tissues, exudates, or blood. Evidence: TAS. Frequency: Frequent (HP:0040282). (ORPHA:60026)
- Mediastinal lymphadenopathy (HP:0100721): Swelling of lymph nodes within the mediastinum, the central compartment of the thoracic cavities that contains the heart and the great vessels, the esophagus, and trachea and other structures including lymph nodes. Evidence: TAS. Frequency: Frequent (HP:0040282). (ORPHA:60026)
- Dyspnea (HP:0002094): Difficult or labored breathing. Dyspnea is a subjective feeling only the patient can rate, e.g., on a Borg scale. Evidence: TAS. Frequency: Occasional (HP:0040283). (ORPHA:60026)
- Ground-glass opacification (HP:0025179): On chest radiographs, ground-glass opacity appears as an area of hazy increased lung opacity, usually extensive, within which margins of pulmonary vessels may be indistinct. On CT scans, it appears as hazy increased opacity of lung, with preservation of bronchial and vascular margins. It is caused by partial filling of airspaces, interstitial thickening (due to fluid, cells, and/or fibrosis), partial collapse of alveoli, increased capillary blood volume, or a combination of these, the common factor being the partial displacement of air. Ground-glass opacity is less opaque than consolidation, in which bronchovascular margins are obscured. Evidence: TAS. Frequency: Occasional (HP:0040283). (ORPHA:60026)
- Chest pain (HP:0100749): An unpleasant sensation characterized by physical discomfort (such as pricking, throbbing, or aching) localized to the chest. Evidence: TAS. Frequency: Occasional (HP:0040283). (ORPHA:60026)
- Immunodeficiency (HP:0002721): Failure of the immune system to protect the body adequately from infection, due to the absence or insufficiency of some component process or substance. Evidence: TAS. Frequency: Very rare (HP:0040284). (ORPHA:60026)
- Autoimmune antibody positivity (HP:0030057): The presence of an antibody in the blood circulation that is directed against the organism's own cells or tissues. Evidence: TAS. Frequency: Very rare (HP:0040284). (ORPHA:60026)
These phenotypes are associated with the disease Pulmonary nodular lymphoid hyperplasia (ORPHA:60026).